Phenotypes associated with the disease Acquired generalized lipodystrophy (ORPHA:79086):
- Generalized lipodystrophy (HP:0009064): Generalized degenerative changes of the fat tissue. Evidence: TAS. Frequency: Obligate (HP:0040280). (ORPHA:79086)
- Hyperinsulinemia (HP:0000842): An increased concentration of insulin in the blood. Evidence: TAS. Frequency: Very frequent (HP:0040281). (ORPHA:79086)
- Insulin resistance (HP:0000855): Increased resistance towards insulin, that is, diminished effectiveness of insulin in reducing blood glucose levels. Evidence: TAS. Frequency: Very frequent (HP:0040281). (ORPHA:79086)
- Insulin-resistant diabetes mellitus (HP:0000831): A type of diabetes mellitus related not to lack of insulin but rather to lack of response to insulin on the part of the target tissues of insulin such as muscle, fat, and liver cells. This type of diabetes is typically associated with increases both in blood glucose concentrations as well as in fasting and postprandial serum insulin levels. Evidence: TAS. Frequency: Frequent (HP:0040282). (ORPHA:79086)
- Hepatic steatosis (HP:0001397): Steatosis is a term used to denote lipid accumulation within hepatocytes. Evidence: TAS. Frequency: Frequent (HP:0040282). (ORPHA:79086)
- Cardiomyopathy (HP:0001638): A myocardial disorder in which the heart muscle is structurally and functionally abnormal, in the absence of coronary artery disease, hypertension, valvular disease and congenital heart disease sufficient to cause the observed myocardial abnormality. Evidence: TAS. Frequency: Frequent (HP:0040282). (ORPHA:79086)
- Autoimmunity (HP:0002960): The occurrence of an immune reaction against the organism's own cells or tissues. Evidence: TAS. Frequency: Frequent (HP:0040282). (ORPHA:79086)
- Abnormal circulating lipid concentration (HP:0003119): Any deviation from the normal concentration of a lipid in the blood circulation. Evidence: TAS. Frequency: Frequent (HP:0040282). (ORPHA:79086)
- Calf muscle pseudohypertrophy (HP:0003707): Enlargement of the muscles of the calf due to their replacement by connective tissue or fat. Evidence: TAS. Frequency: Frequent (HP:0040282). (ORPHA:79086)
- Progeroid facial appearance (HP:0005328): A degree of wrinkling of the facial skin that is more than expected for the age of the individual, leading to a prematurely aged appearance. Evidence: TAS. Frequency: Frequent (HP:0040282). (ORPHA:79086)
- Abnormal cardiovascular system physiology (HP:0011025): Abnormal functionality of the cardiovascular system. Evidence: TAS. Frequency: Frequent (HP:0040282). (ORPHA:79086)
- Proteinuria (HP:0000093): Increased levels of protein in the urine. Evidence: TAS. Frequency: Occasional (HP:0040283). (ORPHA:79086)
- Polycystic ovaries (HP:0000147). Evidence: TAS. Frequency: Occasional (HP:0040283). (ORPHA:79086)
- Hypertension (HP:0000822): The presence of chronic increased pressure in the systemic arterial system. Evidence: TAS. Frequency: Occasional (HP:0040283). (ORPHA:79086)
- Acanthosis nigricans (HP:0000956): A dermatosis characterized by thickened, hyperpigmented plaques, typically on the intertriginous surfaces and neck. Evidence: TAS. Frequency: Occasional (HP:0040283). (ORPHA:79086)
- Cirrhosis (HP:0001394): A chronic disorder of the liver in which liver tissue becomes scarred and is partially replaced by regenerative nodules and fibrotic tissue resulting in loss of liver function. Evidence: TAS. Frequency: Occasional (HP:0040283). (ORPHA:79086)
- Acute pancreatitis (HP:0001735): A acute form of pancreatitis. Evidence: TAS. Frequency: Occasional (HP:0040283). (ORPHA:79086)
- Hypertriglyceridemia (HP:0002155): An abnormal increase in the level of triglycerides in the blood. Evidence: TAS. Frequency: Occasional (HP:0040283). (ORPHA:79086)
- Generalized hirsutism (HP:0002230): Abnormally increased hair growth over much of the entire body. Evidence: TAS. Frequency: Occasional (HP:0040283). (ORPHA:79086)
- Hepatomegaly (HP:0002240): Abnormally increased size of the liver. Evidence: TAS. Frequency: Occasional (HP:0040283). (ORPHA:79086)
- Myopathy (HP:0003198): A disorder of muscle unrelated to impairment of innervation or neuromuscular junction. Evidence: TAS. Frequency: Occasional (HP:0040283). (ORPHA:79086)
- Abnormality of complement system (HP:0005339): An abnormality of the complement system. Evidence: TAS. Frequency: Occasional (HP:0040283). (ORPHA:79086)
- Accelerated skeletal maturation (HP:0005616): An abnormally increased rate of skeletal maturation. Accelerated skeletal maturation can be diagnosed on the basis of an estimation of the bone age from radiographs of specific bones in the human body. Evidence: TAS. Frequency: Occasional (HP:0040283). (ORPHA:79086)
- Generalized hyperpigmentation (HP:0007440). Evidence: TAS. Frequency: Occasional (HP:0040283). (ORPHA:79086)
- Panniculitis (HP:0012490): Inflammation of subcutaneous adipose tissue. Evidence: TAS. Frequency: Occasional (HP:0040283). (ORPHA:79086)
- Lymphoma (HP:0002665): A cancer originating in lymphocytes and presenting as a solid tumor of lymhpoid cells. Evidence: TAS. Frequency: Very rare (HP:0040284). (ORPHA:79086)
- Astrocytoma (HP:0009592): Astrocytoma is a neoplasm of the central nervous system derived from astrocytes. Astrocytes are a type of glial cell, and thus astrocytoma is a subtype of glioma. Evidence: TAS. Frequency: Very rare (HP:0040284). (ORPHA:79086)
- Unicameral bone cyst (HP:0012064): A benign fluid filled simple cyst of bone filled with serous fluid. Evidence: TAS. Frequency: Very rare (HP:0040284). (ORPHA:79086)